Phenotypes associated with the disease benign prostatic hyperplasia (OMIM:600082):
- Infantile onset (HP:0003593): Onset of signs or symptoms of disease between 28 days to one year of life. Evidence: IEA. (OMIM:600082)
- Benign prostatic hyperplasia (HP:0008711): The presence of non-malignant hyperplasia of the prostate. Evidence: IEA. (OMIM:600082)
- Autosomal dominant inheritance (HP:0000006): A mode of inheritance that is observed for traits related to a gene encoded on one of the autosomes (i.e., the human chromosomes 1-22) in which a trait manifests in heterozygotes. In the context of medical genetics, an autosomal dominant disorder is caused when a single copy of the mutant allele is present. Males and females are affected equally, and can both transmit the disorder with a risk of 50% for each child of inheriting the mutant allele. Evidence: IEA. (OMIM:600082)